Phenotypes associated with the disease BLOOD GROUP--LUTHERAN INHIBITOR; INLU (OMIM:111150):
- Absence of Lutheran antigen on erythrocytes (HP:0010971): Absence of the Lutheran antigen (a type I integral membrane glycoprotein) from the surface of red blood cells. Evidence: IEA. (OMIM:111150)
- Autosomal dominant inheritance (HP:0000006): A mode of inheritance that is observed for traits related to a gene encoded on one of the autosomes (i.e., the human chromosomes 1-22) in which a trait manifests in heterozygotes. In the context of medical genetics, an autosomal dominant disorder is caused when a single copy of the mutant allele is present. Males and females are affected equally, and can both transmit the disorder with a risk of 50% for each child of inheriting the mutant allele. Evidence: TAS. (OMIM:111150)